- Bilateral tonic-clonic seizure (HP:0002069): A bilateral tonic-clonic seizure is a seizure defined by a tonic (bilateral increased tone, lasting seconds to minutes) and then a clonic (bilateral sustained rhythmic jerking) phase. Evidence: PCS. Frequency: 4/5. Onset: Juvenile onset (HP:0003621). (PMID:24812067)
- Delayed speech and language development (HP:0000750): A degree of language development that is significantly below the norm for a child of a specified age. Evidence: PCS. Frequency: 5/5. (PMID:24812067)
- X-linked recessive inheritance (HP:0001419): A mode of inheritance that is observed for recessive traits related to a gene encoded on the X chromosome. In the context of medical genetics, X-linked recessive disorders manifest in males (who have one copy of the X chromosome and are thus hemizygotes), but generally not in female heterozygotes who have one mutant and one normal allele. Evidence: PCS. (PMID:24812067)
- Generalized non-motor (absence) seizure (HP:0002121): A generalized non-motor (absence) seizure is a type of a type of dialeptic seizure that is of electrographically generalized onset. It is a generalized seizure characterized by an interruption of activities, a blank stare, and usually the person will be unresponsive when spoken to. Any ictal motor phenomena are minor in comparison to these non-motor features. Evidence: PCS. Frequency: 4/5. Onset: Juvenile onset (HP:0003621). (PMID:24812067)
- Abnormal facial shape (HP:0001999): An abnormal morphology (form) of the face or its components. Evidence: PCS. (PMID:24812067)
- Intellectual disability (HP:0001249): The term intellectual disability or intellectual developmental disorder is used to describe significantly sub-average intellectual and adaptive functioning based on clinical assessment and as measured by individually administered, appropriately normed, standardized and validated tests of intellectual functioning and adaptive behavior, with onset during the developmental period from infancy through adolescence. Evidence: PCS. Frequency: 5/5. (PMID:24812067)
These phenotypes are associated with the disease intellectual disability, X-linked 100 (OMIM:300923).